Phenotypes associated with the disease Juvenile sialidosis type 2 (ORPHA:93399):
- Coarse facial features (HP:0000280): Absence of fine and sharp appearance of brows, nose, lips, mouth, and chin, usually because of rounded and heavy features or thickened skin with or without thickening of subcutaneous and bony tissues. Evidence: TAS. Frequency: Very frequent (HP:0040281). (ORPHA:93399)
- Dysostosis multiplex (HP:0000943). Evidence: TAS. Frequency: Very frequent (HP:0040281). (ORPHA:93399)
- Global developmental delay (HP:0001263): A delay in the achievement of motor or mental milestones in the domains of development of a child, including motor skills, speech and language, cognitive skills, and social and emotional skills. This term should only be used to describe children younger than five years of age. Evidence: TAS. Frequency: Very frequent (HP:0040281). (ORPHA:93399)
- Visceromegaly (HP:0003271): Abnormal increased size of the viscera of the abdomen. Evidence: TAS. Frequency: Very frequent (HP:0040281). (ORPHA:93399)
- Hearing impairment (HP:0000365): A decreased magnitude of the sensory perception of sound. Evidence: TAS. Frequency: Frequent (HP:0040282). (ORPHA:93399)
- Cataract (HP:0000518): A cataract is an opacity or clouding that develops in the crystalline lens of the eye or in its capsule. Evidence: TAS. Frequency: Frequent (HP:0040282). (ORPHA:93399)
- Seizure (HP:0001250): A seizure is an intermittent abnormality of nervous system physiology characterized by a transient occurrence of signs and/or symptoms due to abnormal excessive or synchronous neuronal activity in the brain. Evidence: TAS. Frequency: Frequent (HP:0040282). (ORPHA:93399)
- Floppy infant (HP:0008947): Floppiness/hypotonia is defined as reduced resistance to passive movement of joints. Physical examination of floppy/hypotonic infants shows head lag, lack of shoulder and elbow muscle contraction on traction response, inability to tighten the shoulder girdle muscles (or slipping through) when held under the axillae, scarf sign (when the arm is pulled to the opposite side, the arm wraps around the neck with the elbow crossing midline), hyperdorsiflexion of the feet, easy apposition of the thumb against the forearm, feet touching the cheek with ease and without discomfort, frog leg position, and inverted U sign on ventral suspension (head, arms, and legs hanging down without elbow or knee flexion and the trunk rounded in a dome shape). Evidence: TAS. Frequency: Frequent (HP:0040282). (ORPHA:93399)
- Cherry red spot of the macula (HP:0010729): Pallor of the perifoveal macula of the retina with appearance of a small circular reddish choroid shape as seen through the fovea centralis due to relative transparency of the macula. Evidence: TAS. Frequency: Frequent (HP:0040282). (ORPHA:93399)
- Inguinal hernia (HP:0000023): Protrusion of the contents of the abdominal cavity through the inguinal canal. Evidence: TAS. Frequency: Occasional (HP:0040283). (ORPHA:93399)
- Abnormality of the kidney (HP:0000077): An abnormality of the kidney. Evidence: TAS. Frequency: Occasional (HP:0040283). (ORPHA:93399)
- Gingival overgrowth (HP:0000212): Hyperplasia of the gingiva (that is, a thickening of the soft tissue overlying the alveolar ridge. The degree of thickening ranges from involvement of the interdental papillae alone to gingival overgrowth covering the entire tooth crown. Evidence: TAS. Frequency: Occasional (HP:0040283). (ORPHA:93399)
- Low-set ears (HP:0000369): Upper insertion of the ear to the scalp below an imaginary horizontal line drawn between the inner canthi of the eye and extending posteriorly to the ear. Evidence: TAS. Frequency: Occasional (HP:0040283). (ORPHA:93399)
- Strabismus (HP:0000486): A misalignment of the eyes so that the visual axes deviate from bifoveal fixation. The classification of strabismus may be based on a number of features including the relative position of the eyes, whether the deviation is latent or manifest, intermittent or constant, concomitant or otherwise and according to the age of onset and the relevance of any associated refractive error. Evidence: TAS. Frequency: Occasional (HP:0040283). (ORPHA:93399)
- Visual loss (HP:0000572): Loss of visual acuity (implying that vision was better at a certain time point in life). Otherwise the term reduced visual acuity should be used (or a subclass of that). Evidence: TAS. Frequency: Occasional (HP:0040283). (ORPHA:93399)
- Nystagmus (HP:0000639): Rhythmic, involuntary oscillations of one or both eyes related to abnormality in fixation, conjugate gaze, or vestibular mechanisms. Evidence: TAS. Frequency: Occasional (HP:0040283). (ORPHA:93399)
- Optic atrophy (HP:0000648): Atrophy of the optic nerve. Optic atrophy results from the death of the retinal ganglion cell axons that comprise the optic nerve and manifesting as a pale optic nerve on fundoscopy. Evidence: TAS. Frequency: Occasional (HP:0040283). (ORPHA:93399)
- Ataxia (HP:0001251): Ataxia refers to impaired coordination of voluntary muscle movement. Cerebellar ataxia refers to ataxia due to dysfunction of the cerebellum. This causes a variety of elementary neurological deficits including asynergy (lack of coordination between muscles, limbs and joints), dysmetria (lack of ability to judge distances that can lead to under- or overshoot in grasping movements), and dysdiadochokinesia (inability to perform rapid movements requiring antagonizing muscle groups to be switched on and off repeatedly). Evidence: TAS. Frequency: Occasional (HP:0040283). (ORPHA:93399)
- Spasticity (HP:0001257): A motor disorder characterized by a velocity-dependent increase in tonic stretch reflexes with increased muscle tone, exaggerated (hyperexcitable) tendon reflexes. Evidence: TAS. Frequency: Occasional (HP:0040283). (ORPHA:93399)
- Motor delay (HP:0001270): A type of Developmental delay characterized by a delay in acquiring motor skills. Evidence: TAS. Frequency: Occasional (HP:0040283). (ORPHA:93399)
- Dysmetria (HP:0001310): A type of ataxia characterized by the inability to carry out movements with the correct range and motion across the plane of more than one joint related to incorrect estimation of the distances required for targeted movements. Evidence: TAS. Frequency: Occasional (HP:0040283). (ORPHA:93399)
- Myoclonus (HP:0001336): Very brief, involuntary random muscular contractions occurring at rest, in response to sensory stimuli, or accompanying voluntary movements. Evidence: TAS. Frequency: Occasional (HP:0040283). (ORPHA:93399)
- Hepatosplenomegaly (HP:0001433): Simultaneous enlargement of the liver and spleen. Evidence: TAS. Frequency: Occasional (HP:0040283). (ORPHA:93399)
- Umbilical hernia (HP:0001537): Protrusion of abdominal contents through a defect in the abdominal wall musculature around the umbilicus. Skin and subcutaneous tissue overlie the defect. Evidence: TAS. Frequency: Occasional (HP:0040283). (ORPHA:93399)
- Dysphonia (HP:0001618): Difficulty in speaking due to a physical disorder of the mouth, tongue, throat, or vocal cords. Associated with a known physical or neurological cause. Evidence: TAS. Frequency: Occasional (HP:0040283). (ORPHA:93399)
- Abnormal heart morphology (HP:0001627): Any structural anomaly of the heart. Evidence: TAS. Frequency: Occasional (HP:0040283). (ORPHA:93399)
- Dysphagia (HP:0002015): Difficulty in swallowing. Evidence: TAS. Frequency: Occasional (HP:0040283). (ORPHA:93399)
- Lower limb spasticity (HP:0002061): Spasticity (velocity-dependent increase in tonic stretch reflexes with increased muscle tone and hyperexcitable tendon reflexes) in the muscles of the lower limbs, hips, and pelvis. Evidence: TAS. Frequency: Occasional (HP:0040283). (ORPHA:93399)
- Abnormality of the respiratory system (HP:0002086): An abnormality of the respiratory system, which include the airways, lungs, and the respiratory muscles. Evidence: TAS. Frequency: Occasional (HP:0040283). (ORPHA:93399)
- Generalized myoclonic seizure (HP:0002123): A generalized myoclonic seizure is a type of generalized motor seizure characterized by bilateral, sudden, brief (<100 ms) involuntary single or multiple contraction of muscles or muscle groups of variable topography (axial, proximal limb, distal). Myoclonus is less regularly repetitive and less sustained than is clonus. Evidence: TAS. Frequency: Occasional (HP:0040283). (ORPHA:93399)
- Hepatomegaly (HP:0002240): Abnormally increased size of the liver. Evidence: TAS. Frequency: Occasional (HP:0040283). (ORPHA:93399)
- Loss of ambulation (HP:0002505): Inability to walk in a person who previous had the ability to walk. Evidence: TAS. Frequency: Occasional (HP:0040283). (ORPHA:93399)
- Abnormal vertebral body morphology (HP:0003312): Abnormal form of vertebral body, which is the central cylindrical portion of the vertebra that together with other structures such as the vertebral arch, pedicles, laminae, spinous process, transverse processes, and articular facets makes up a vertebra. Evidence: TAS. Frequency: Occasional (HP:0040283). (ORPHA:93399)
- Generalized hypertrichosis (HP:0004554): Generalized excessive, abnormal hairiness. Evidence: TAS. Frequency: Occasional (HP:0040283). (ORPHA:93399)
- Corneal opacity (HP:0007957): A reduction of corneal clarity. Evidence: TAS. Frequency: Occasional (HP:0040283). (ORPHA:93399)
- Underdeveloped supraorbital ridges (HP:0009891): Flatness of the supraorbital portion of the frontal bones. Evidence: TAS. Frequency: Occasional (HP:0040283). (ORPHA:93399)
- Protruding tongue (HP:0010808): Tongue extending beyond the alveolar ridges or teeth at rest. Evidence: TAS. Frequency: Occasional (HP:0040283). (ORPHA:93399)
- Severe intellectual disability (HP:0010864): Severe intellectual disability (ID) is defined as a type of ID characterized by severely sub-average adaptive functioning and intellectual functioning, with an intelligence quotient (IQ) the range of 20-34. Evidence: TAS. Frequency: Very rare (HP:0040284). (ORPHA:93399)